- Microcephaly (HP:0000252): Head circumference below 2 standard deviations below the mean for age and gender. Evidence: TAS. Frequency: Very frequent (HP:0040281). (ORPHA:1422)
- Macrotia (HP:0000400): Median longitudinal ear length greater than two standard deviations above the mean and median ear width greater than two standard deviations above the mean (objective); or, apparent increase in length and width of the pinna (subjective). Evidence: TAS. Frequency: Very frequent (HP:0040281). (ORPHA:1422)
- Telecanthus (HP:0000506): Distance between the inner canthi more than two standard deviations above the mean (objective); or, apparently increased distance between the inner canthi. Evidence: TAS. Frequency: Very frequent (HP:0040281). (ORPHA:1422)
- Narrow chest (HP:0000774): Reduced width of the chest from side to side, associated with a reduced distance from the sternal notch to the tip of the shoulder. Evidence: TAS. Frequency: Very frequent (HP:0040281). (ORPHA:1422)
- Intellectual disability (HP:0001249): The term intellectual disability or intellectual developmental disorder is used to describe significantly sub-average intellectual and adaptive functioning based on clinical assessment and as measured by individually administered, appropriately normed, standardized and validated tests of intellectual functioning and adaptive behavior, with onset during the developmental period from infancy through adolescence. Evidence: TAS. Frequency: Very frequent (HP:0040281). (ORPHA:1422)
- Intrauterine growth retardation (HP:0001511): An abnormal restriction of fetal growth with fetal weight below the tenth percentile for gestational age. Evidence: TAS. Frequency: Very frequent (HP:0040281). (ORPHA:1422)
- Abnormal pelvic girdle bone morphology (HP:0002644): An abnormality of the bony pelvic girdle, which is a ring of bones connecting the vertebral column to the femurs. Evidence: TAS. Frequency: Very frequent (HP:0040281). (ORPHA:1422)
- Micromelia (HP:0002983): The presence of abnormally small extremities. Evidence: TAS. Frequency: Very frequent (HP:0040281). (ORPHA:1422)
- Abnormal shoulder morphology (HP:0003043): An abnormality of the shoulder, which is defined as the structures surrounding the shoulder joint where the humerus attaches to the scapula. Evidence: TAS. Frequency: Very frequent (HP:0040281). (ORPHA:1422)
- Severe short stature (HP:0003510): A severe degree of short stature, more than -4 SD from the mean corrected for age and sex. Evidence: TAS. Frequency: Very frequent (HP:0040281). (ORPHA:1422)
- Increased skull ossification (HP:0004330): An increase in the magnitude or amount of ossification of the skull. Evidence: TAS. Frequency: Very frequent (HP:0040281). (ORPHA:1422)
- Broad long bones (HP:0005622): Increased cross-section (diameter) of the long bones. Note that widening may primarily affect specific regions of long bones (e.g., diaphysis or metaphysis), but this should be coded separately. Evidence: TAS. Frequency: Very frequent (HP:0040281). (ORPHA:1422)
- Short phalanx of finger (HP:0009803): Short (hypoplastic) phalanx of finger, affecting one or more phalanges. Evidence: TAS. Frequency: Very frequent (HP:0040281). (ORPHA:1422)
- Short metacarpal (HP:0010049): Diminished length of one or more metacarpal bones in relation to the others of the same hand or to the contralateral metacarpal. Evidence: TAS. Frequency: Very frequent (HP:0040281). (ORPHA:1422)
- Male pseudohermaphroditism (HP:0000037): Hermaphroditism refers to a discrepancy between the morphology of the gonads and that of the external genitalia. In male pseudohermaphroditism, the genotype is male (XY) and the external genitalia are imcompletely virilized, ambiguous, or complete female. If gonads are present, they are testes. Evidence: TAS. Frequency: Frequent (HP:0040282). (ORPHA:1422)
- Strabismus (HP:0000486): A misalignment of the eyes so that the visual axes deviate from bifoveal fixation. The classification of strabismus may be based on a number of features including the relative position of the eyes, whether the deviation is latent or manifest, intermittent or constant, concomitant or otherwise and according to the age of onset and the relevance of any associated refractive error. Evidence: TAS. Frequency: Frequent (HP:0040282). (ORPHA:1422)
- Deeply set eye (HP:0000490): An eye that is more deeply recessed into the plane of the face than is typical. Evidence: TAS. Frequency: Frequent (HP:0040282). (ORPHA:1422)
- Chorioretinal coloboma (HP:0000567): Absence of a region of the retina, retinal pigment epithelium, and choroid. Evidence: TAS. Frequency: Frequent (HP:0040282). (ORPHA:1422)
- Blepharophimosis (HP:0000581): A fixed reduction in the vertical distance between the upper and lower eyelids with short palpebral fissures. Evidence: TAS. Frequency: Frequent (HP:0040282). (ORPHA:1422)
- Miosis (HP:0000616): Abnormal (non-physiological) constriction of the pupil. Evidence: TAS. Frequency: Frequent (HP:0040282). (ORPHA:1422)
- Cerebral hypoplasia (HP:0006872): Underdevelopment of the cerebrum. Evidence: TAS. Frequency: Frequent (HP:0040282). (ORPHA:1422)
- Hypoplasia of the iris (HP:0007676): Congenital underdevelopment of the iris. Evidence: TAS. Frequency: Frequent (HP:0040282). (ORPHA:1422)
These phenotypes are associated with the disease Chondrodysplasia-difference of sex development syndrome (ORPHA:1422).